Phenotypes associated with the disease glaucoma-sleep apnea syndrome (OMIM:137763):
- Sleep apnea (HP:0010535): An intermittent cessation of airflow at the mouth and nose during sleep is known as sleep apnea. Apneas that last at least 10 seconds are considered significant, but individuals with sleep apnea may experience apneas lasting from 20 seconds up to 2 or 3 minutes. Patients may have up to 15 events per hour of sleep. Evidence: IEA. (OMIM:137763)